- Abnormality of the skin (HP:0000951): An abnormality of the skin. Evidence: TAS. Frequency: Very frequent (HP:0040281). (ORPHA:220402)
- Abnormal skin pigmentation (HP:0001000): An abnormality of the pigmentation of the skin. Evidence: TAS. Frequency: Very frequent (HP:0040281). (ORPHA:220402)
- Hypopigmented skin patches (HP:0001053). Evidence: TAS. Frequency: Very frequent (HP:0040281). (ORPHA:220402)
- Dysphagia (HP:0002015): Difficulty in swallowing. Evidence: TAS. Frequency: Frequent (HP:0040282). (ORPHA:220402)
- Nausea and vomiting (HP:0002017): Nausea is a commonly encountered symptom that has been defined as an unpleasant painless subjective feeling that one will imminently vomit. Vomiting has been defined as the forceful expulsion of the contents of the stomach, duodenum, or jejunum through the oral cavity. While nausea and vomiting are often thought to exist on a temporal continuum, this is not always the case. There are situations when severe nausea may be present without emesis and less frequently, when emesis may be present without preceding nausea. Evidence: TAS. Frequency: Frequent (HP:0040282). (ORPHA:220402)
- Gastroesophageal reflux (HP:0002020): A condition in which the stomach contents leak backwards from the stomach into the esophagus through the lower esophageal sphincter. Evidence: TAS. Frequency: Frequent (HP:0040282). (ORPHA:220402)
- Pulmonary arterial hypertension (HP:0002092): Pulmonary hypertension is defined mean pulmonary artery pressure of 25mmHg or more and pulmonary capillary wedge pressure of 15mmHg or less when measured by right heart catheterisation at rest and in a supine position. Evidence: TAS. Frequency: Occasional (HP:0040283). (ORPHA:220402)
- Pulmonary fibrosis (HP:0002206): Replacement of normal lung tissues by fibroblasts and collagen. Evidence: TAS. Frequency: Occasional (HP:0040283). (ORPHA:220402)
- Autoimmunity (HP:0002960): The occurrence of an immune reaction against the organism's own cells or tissues. Evidence: TAS. Frequency: Very frequent (HP:0040281). (ORPHA:220402)
- Foot joint contracture (HP:0008366): Contractures of one or more joints of the feet meaning chronic loss of joint motion due to structural changes in non-bony tissue. Evidence: TAS. Frequency: Occasional (HP:0040283). (ORPHA:220402)
- Joint contracture of the hand (HP:0009473): Contractures of one ore more joints of the hands meaning chronic loss of joint motion due to structural changes in non-bony tissue. Evidence: TAS. Frequency: Occasional (HP:0040283). (ORPHA:220402)
- Mucosal telangiectasiae (HP:0100579): Telangiectasia of the mucosa, the mucous membranes which are involved in absorption and secretion that line cavities that are exposed to the external environment and internal organs. Evidence: TAS. Frequency: Frequent (HP:0040282). (ORPHA:220402)
- Telangiectasia of the skin (HP:0100585): Presence of small, permanently dilated blood vessels near the surface of the skin, visible as small focal red lesions. Evidence: TAS. Frequency: Frequent (HP:0040282). (ORPHA:220402)
- Narrow foramen obturatorium (HP:0100958): Decreased width of the foramen obturatorium. The foramen obturatorium (also known as the obturator foramen) is a hole located between the ischium and pubis bones of the pelvis. Evidence: TAS. Frequency: Very frequent (HP:0040281). (ORPHA:220402)
- Skin ulcer (HP:0200042): A discontinuity of the skin exhibiting complete loss of the epidermis and often portions of the dermis and even subcutaneous fat. Evidence: TAS. Frequency: Frequent (HP:0040282). (ORPHA:220402)
These phenotypes are associated with the disease Limited cutaneous systemic sclerosis (ORPHA:220402).